Phenotypes associated with the disease nystagmus 5, congenital, X-linked (OMIM:300589):
- Hyperopic astigmatism (HP:0000484): A form of astigmatism in which one meridian is hyperopic while the one at a right angle to it has no refractive error. Evidence: TAS. (OMIM:300589)
- Strabismus (HP:0000486): A misalignment of the eyes so that the visual axes deviate from bifoveal fixation. The classification of strabismus may be based on a number of features including the relative position of the eyes, whether the deviation is latent or manifest, intermittent or constant, concomitant or otherwise and according to the age of onset and the relevance of any associated refractive error. Evidence: TAS. (OMIM:300589)
- Nystagmus (HP:0000639): Rhythmic, involuntary oscillations of one or both eyes related to abnormality in fixation, conjugate gaze, or vestibular mechanisms. Evidence: TAS. Onset: Infantile onset (HP:0003593). (OMIM:300589)
- X-linked dominant inheritance (HP:0001423): A mode of inheritance that is observed for dominant traits related to a gene encoded on the X chromosome. In the context of medical genetics, X-linked dominant disorders tend to manifest very severely in affected males. The severity of manifestation in females may depend on the degree of skewed X inactivation. Evidence: TAS. (OMIM:300589)
- Abnormal stereopsis (HP:0011515): Inability to make fine depth discriminations from parallax provided by the two eyes' different positions on the head. Evidence: TAS. (OMIM:300589)